Phenotypes associated with the disease chloramphenicol toxicity (OMIM:515000):
- Aplastic anemia (HP:0001915): Aplastic anemia is defined as pancytopenia with a hypocellular marrow. Evidence: IEA. (OMIM:515000)